Phenotypes associated with the disease Athrombia, essential (OMIM:209050):
- Abnormal bleeding (HP:0001892): An abnormal susceptibility to bleeding, often referred to as a bleeding diathesis. A bleeding diathesis may be related to vascular, platelet and coagulation defects. Evidence: IEA. (OMIM:209050)
- Impaired platelet adhesion (HP:0008352): An abnormality of adhesion of thrombocytes. Normally, platelets adhere to collagen in the vascular subendothelium within seconds of injury via a receptor made up of glycoprotein Ia and IIa and GPVI and to vWF via receptor GPIb/IX/V. The adherent platelets then release granules that lead to platelet activation and aggregation. Evidence: IEA. (OMIM:209050)
- Impaired platelet aggregation (HP:0003540): An impairment in the rate and degree to which platelets aggregate after the addition of an agonist that stimulates platelet clumping. Platelet aggregation is measured using aggregometer to measure the optical density of platelet-rich plasma, whereby platelet aggregation causes the plasma to become more transparent. Evidence: TAS. (OMIM:209050)
- Prolonged bleeding time (HP:0003010): Prolongation of the time taken for a standardized skin cut of fixed depth and length to stop bleeding. Evidence: TAS. (OMIM:209050)
- Autosomal recessive inheritance (HP:0000007): A mode of inheritance that is observed for traits related to a gene encoded on one of the autosomes (i.e., the human chromosomes 1-22) in which a trait manifests in individuals with two pathogenic alleles, either homozygotes (two copies of the same mutant allele) or compound heterozygotes (whereby each copy of a gene has a distinct mutant allele). Evidence: IEA. (OMIM:209050)